- Congenital onset (HP:0003577): A phenotypic abnormality that is present at birth. Evidence: PCS. (PMID:30982135)
- Postaxial polydactyly type A (HP:0005696): Supernumerary digits located at the ulnar side of the hand with a complete extra finger and extra metacarpal. Evidence: PCS. (PMID:30982135)
- Postaxial hand polydactyly (HP:0001162): Supernumerary digits located at the ulnar side of the hand (that is, on the side with the fifth finger). Evidence: PCS. (PMID:30982135)
- Autosomal recessive inheritance (HP:0000007): A mode of inheritance that is observed for traits related to a gene encoded on one of the autosomes (i.e., the human chromosomes 1-22) in which a trait manifests in individuals with two pathogenic alleles, either homozygotes (two copies of the same mutant allele) or compound heterozygotes (whereby each copy of a gene has a distinct mutant allele). Evidence: IEA. (OMIM:618498)
- Postaxial foot polydactyly (HP:0001830): Polydactyly of the foot most commonly refers to the presence of six toes on one foot. Postaxial polydactyly affects the lateral ray and the duplication may range from a well-formed articulated digit to a rudimentary digit. Evidence: IEA. (PMID:30982135)
These phenotypes are associated with the disease polydactyly, postaxial, type a10 (OMIM:618498).